Phenotypes associated with the disease autosomal dominant nonsyndromic hearing loss 22 (OMIM:606346):
- Progressive sensorineural hearing impairment (HP:0000408): A progressive form of sensorineural hearing impairment. Evidence: TAS. (OMIM:606346)
- Sensorineural hearing impairment (HP:0000407): A type of hearing impairment in one or both ears related to an abnormal functionality of the cochlear nerve. Evidence: TAS. (OMIM:606346)
- Autosomal dominant inheritance (HP:0000006): A mode of inheritance that is observed for traits related to a gene encoded on one of the autosomes (i.e., the human chromosomes 1-22) in which a trait manifests in heterozygotes. In the context of medical genetics, an autosomal dominant disorder is caused when a single copy of the mutant allele is present. Males and females are affected equally, and can both transmit the disorder with a risk of 50% for each child of inheriting the mutant allele. Evidence: TAS. (OMIM:606346)